Phenotypes associated with the disease Intermediate uveitis (ORPHA:279914):
- Psoriasiform dermatitis (HP:0003765): A skin abnormality characterized by redness and irritation, with thick, red skin that displays flaky, silver-white patches (scales). Evidence: TAS. Frequency: Very rare (HP:0040284). (ORPHA:279914)
- Chronic infection (HP:0031035): Presence of a protracted or persistent infection by a pathogen potentially related to an underlying abnormality of the immune system that is not able to clear the infection. Evidence: TAS. Frequency: Very rare (HP:0040284). (ORPHA:279914)
- Macular scar (HP:0200056): Fibrous connective tissue consequent upon healing of a wound (i.e., a scar) located in the macula. Evidence: TAS. Frequency: Very rare (HP:0040284). (ORPHA:279914)
- Macular edema (HP:0040049): Thickening of the retina that takes place due to accumulation of extracellular fluid in the macula as a nonspecific response to blood-retinal barrier breakdown. It can either have a cystoid aspect in the fovea, or a more diffuse aspect. Evidence: TAS. Frequency: Frequent (HP:0040282). (ORPHA:279914)
- Glaucoma (HP:0000501): Glaucoma refers loss of retinal ganglion cells in a characteristic pattern of optic neuropathy usually associated with increased intraocular pressure. Evidence: TAS. Frequency: Occasional (HP:0040283). (ORPHA:279914)
- Cataract (HP:0000518): A cataract is an opacity or clouding that develops in the crystalline lens of the eye or in its capsule. Evidence: TAS. Frequency: Occasional (HP:0040283). (ORPHA:279914)
- Band keratopathy (HP:0000585): An abnormality of the cornea characterized by the deposition of calcium in a band across the central cornea, leading to decreased vision, foreign body sensation, and ocular irritation. Evidence: TAS. Frequency: Occasional (HP:0040283). (ORPHA:279914)
- Vasculitis (HP:0002633): Inflammation of blood vessel. Evidence: TAS. Frequency: Occasional (HP:0040283). (ORPHA:279914)
- Reduced visual acuity (HP:0007663). Evidence: TAS. Frequency: Occasional (HP:0040283). (ORPHA:279914)
- Posterior synechiae of the anterior chamber (HP:0011484): Adhesions between the iris and the lens. Evidence: TAS. Frequency: Occasional (HP:0040283). (ORPHA:279914)
- Cystoid macular edema (HP:0011505): Cystoid thickening of the retina that takes place due to accumulation of extracellular fluid in the macula as a nonspecific response to blood-retinal barrier breakdown. Histological studies show that radially orientated cystoid spaces consisting of ophthalmoscopically clear fluid are often clinically detectable in the macula area. Evidence: TAS. Frequency: Occasional (HP:0040283). (ORPHA:279914)
- Anterior uveitis (HP:0012122): Inflammation of the uveal tract in which the primary site of inflammation is the anterior chamber. Evidence: TAS. Frequency: Occasional (HP:0040283). (ORPHA:279914)
- Vitreous haze (HP:0030652): Vitreous haze is the obscuration of fundus details by vitreous cells and protein exudation. Evidence: TAS. Frequency: Occasional (HP:0040283). (ORPHA:279914)
- Vitreous snowballs (HP:0030661): Yellow-white inflammatory aggregates in the vitreous that are found in the midvitreous and inferior periphery. Evidence: TAS. Frequency: Occasional (HP:0040283). (ORPHA:279914)
- Epiretinal membrane (HP:0100014): An epiretinal membrane is a thin sheet of fibrous tissue on the surface of the retina along the inner limiting membrane. It appears as a greyish semi-translucent avascular membrane over the internal limiting membrane (ILM) on the surface of the retina. Evidence: TAS. Frequency: Occasional (HP:0040283). (ORPHA:279914)
- Optic neuritis (HP:0100653): Inflammation of the optic nerve. Evidence: TAS. Frequency: Occasional (HP:0040283). (ORPHA:279914)
- Vitreous floaters (HP:0100832): Deposits of various size, shape, consistency, refractive index, and motility within the eye's vitreous humor, which is normally transparent. Evidence: TAS. Frequency: Occasional (HP:0040283). (ORPHA:279914)
- Tubulointerstitial nephritis (HP:0001970): A form of inflammation of the kidney affecting the interstitium of the kidneys surrounding the tubules. Evidence: TAS. Frequency: Very rare (HP:0040284). (ORPHA:279914)